Phenotypes associated with the disease pyridoxine-dependent epilepsy caused by ALDH7A1 mutant (OMIM:266100):
- Bilateral tonic-clonic seizure (HP:0002069): A bilateral tonic-clonic seizure is a seizure defined by a tonic (bilateral increased tone, lasting seconds to minutes) and then a clonic (bilateral sustained rhythmic jerking) phase. Evidence: PCS. Frequency: 6/6. (PMID:16491085)
- Delayed speech and language development (HP:0000750): A degree of language development that is significantly below the norm for a child of a specified age. Evidence: PCS. Frequency: 5/6. (PMID:16491085)
- Status epilepticus (HP:0002133): Status epilepticus is a type of prolonged seizure resulting either from the failure of the mechanisms responsible for seizure termination or from the initiation of mechanisms which lead to abnormally prolonged seizures (after time point t1). It is a condition that can have long-term consequences (after time point t2), including neuronal death, neuronal injury, and alteration of neuronal networks, depending on the type and duration of seizures. Evidence: PCS. Frequency: 2/8. (PMID:16491085)
- Strabismus (HP:0000486): A misalignment of the eyes so that the visual axes deviate from bifoveal fixation. The classification of strabismus may be based on a number of features including the relative position of the eyes, whether the deviation is latent or manifest, intermittent or constant, concomitant or otherwise and according to the age of onset and the relevance of any associated refractive error. Evidence: PCS. Frequency: 1/2. (PMID:16491085)
- Generalized myoclonic seizure (HP:0002123): A generalized myoclonic seizure is a type of generalized motor seizure characterized by bilateral, sudden, brief (<100 ms) involuntary single or multiple contraction of muscles or muscle groups of variable topography (axial, proximal limb, distal). Myoclonus is less regularly repetitive and less sustained than is clonus. Evidence: PCS. (PMID:16491085)
- Elevated circulating pipecolic acid concentration (HP:6000268): The concentration of pipecolic acid in the blood circulation is above the upper limit of normal. Evidence: PCS. Frequency: 2/2. (PMID:16491085)
- Global developmental delay (HP:0001263): A delay in the achievement of motor or mental milestones in the domains of development of a child, including motor skills, speech and language, cognitive skills, and social and emotional skills. This term should only be used to describe children younger than five years of age. Evidence: PCS. (PMID:16491085)
- Hypotonia (HP:0001252): Hypotonia is an abnormally low muscle tone (the amount of tension or resistance to movement in a muscle). Even when relaxed, muscles have a continuous and passive partial contraction which provides some resistance to passive stretching. Hypotonia thus manifests as diminished resistance to passive stretching. Hypotonia is not the same as muscle weakness, although the two conditions can co-exist. Evidence: PCS. Frequency: 3/5. (PMID:16491085)
- EEG with burst suppression (HP:0010851): The burst suppression pattern in electroencephalography refers to a characteristic periodic pattern of low voltage (<10 microvolts) suppressed background and a relatively shorter pattern of higher amplitude slow, sharp, and spiking complexes. Evidence: PCS. Frequency: 4/5. (PMID:16491085)
- Elevated circulating alpha-aminoadipic semialdehyde concentration (HP:0034365): Increased concentration of alpha-aminoadipic semialdehyde in the blood circulation. Evidence: PCS. (PMID:16491085)
- Autosomal recessive inheritance (HP:0000007): A mode of inheritance that is observed for traits related to a gene encoded on one of the autosomes (i.e., the human chromosomes 1-22) in which a trait manifests in individuals with two pathogenic alleles, either homozygotes (two copies of the same mutant allele) or compound heterozygotes (whereby each copy of a gene has a distinct mutant allele). Evidence: PCS. (PMID:16491085)
- Hydrocephalus (HP:0000238): Hydrocephalus is an active distension of the ventricular system of the brain resulting from inadequate passage of CSF from its point of production within the cerebral ventricles to its point of absorption into the systemic circulation. Evidence: PCS. Frequency: 2/5. (PMID:16491085)
- Clonic seizure (HP:0020221): A clonic seizure is a type of motor seizure characterized by sustained rhythmic jerking, that is regularly repetitive. Evidence: PCS. Frequency: 6/6. (PMID:16491085)
- Fetal distress (HP:0025116): An intrauterine state characterized by suboptimal values in the fetal heart rate, oxygenation of fetal blood, or other parameters indicative of compromise of the fetus. Signs of fetal distress include repetitive variable decelerations, fetal tachycardia or bradycardia, late decelerations, or low biophysical profile. Evidence: TAS. (OMIM:266100)
- Intellectual disability (HP:0001249): The term intellectual disability or intellectual developmental disorder is used to describe significantly sub-average intellectual and adaptive functioning based on clinical assessment and as measured by individually administered, appropriately normed, standardized and validated tests of intellectual functioning and adaptive behavior, with onset during the developmental period from infancy through adolescence. Evidence: PCS. (PMID:16491085)
- Neonatal respiratory distress (HP:0002643): Respiratory difficulty as newborn. Evidence: PCS. Frequency: 4/5. Onset: Neonatal onset (HP:0003623). (PMID:16491085)
- Prenatal movement abnormality (HP:0001557): An abnormality of fetal movement. Evidence: PCS. Frequency: 3/4. (PMID:16491085)
- Neonatal onset (HP:0003623): Onset of signs or symptoms of disease within the first 28 days of life. Evidence: PCS. Frequency: 7/7. (PMID:16491085)